Phenotypes associated with the disease coumarin resistance (OMIM:122700):
- Abnormality of blood and blood-forming tissues (HP:0001871): An abnormality of the hematopoietic system. Evidence: IEA. (OMIM:122700)
- Autosomal dominant inheritance (HP:0000006): A mode of inheritance that is observed for traits related to a gene encoded on one of the autosomes (i.e., the human chromosomes 1-22) in which a trait manifests in heterozygotes. In the context of medical genetics, an autosomal dominant disorder is caused when a single copy of the mutant allele is present. Males and females are affected equally, and can both transmit the disorder with a risk of 50% for each child of inheriting the mutant allele. Evidence: IEA. (OMIM:122700)